Phenotypes associated with the disease Hypertryptophanemia (ORPHA:2224):
- Increased serum serotonin (HP:0003144): A increased concentration of serotonin in the blood. Evidence: TAS. Frequency: Very frequent (HP:0040281). (ORPHA:2224)
- Tryptophanuria (HP:0003361): An increased concentration of tryptophan in the urine. Evidence: TAS. Frequency: Very frequent (HP:0040281). (ORPHA:2224)
- Hypertryptophanemia (HP:0500134): The concentration of tryptophan in the blood circulation is above the upper limit of normal. Evidence: TAS. Frequency: Very frequent (HP:0040281). (ORPHA:2224)